Phenotypes associated with the disease orofacial cleft 1 (OMIM:119530):
- Cleft palate (HP:0000175): Cleft palate is a developmental defect of the palate resulting from a failure of fusion of the palatine processes and manifesting as a separation of the roof of the mouth (soft and hard palate). Evidence: TAS. (OMIM:119530)
- Congenital onset (HP:0003577): A phenotypic abnormality that is present at birth. Evidence: TAS. (OMIM:119530)
- Autosomal dominant inheritance (HP:0000006): A mode of inheritance that is observed for traits related to a gene encoded on one of the autosomes (i.e., the human chromosomes 1-22) in which a trait manifests in heterozygotes. In the context of medical genetics, an autosomal dominant disorder is caused when a single copy of the mutant allele is present. Males and females are affected equally, and can both transmit the disorder with a risk of 50% for each child of inheriting the mutant allele. Evidence: TAS. (OMIM:119530)
- Cleft upper lip (HP:0000204): A gap or groove in the upper lip. This is a congenital defect resulting from nonfusion of tissues of the lip during embryonal development. Evidence: TAS. (OMIM:119530)